- Autosomal recessive inheritance (HP:0000007): A mode of inheritance that is observed for traits related to a gene encoded on one of the autosomes (i.e., the human chromosomes 1-22) in which a trait manifests in individuals with two pathogenic alleles, either homozygotes (two copies of the same mutant allele) or compound heterozygotes (whereby each copy of a gene has a distinct mutant allele). Evidence: IEA. (OMIM:274800)
- Hypothyroidism (HP:0000821): Deficiency of thyroid hormone. Evidence: IEA. (OMIM:274800)
- Growth delay (HP:0001510): A deficiency or slowing down of growth pre- and postnatally. Evidence: IEA. (OMIM:274800)
- Goiter (HP:0000853): An enlargement of the thyroid gland. Evidence: IEA. (OMIM:274800)
- Intellectual disability (HP:0001249): The term intellectual disability or intellectual developmental disorder is used to describe significantly sub-average intellectual and adaptive functioning based on clinical assessment and as measured by individually administered, appropriately normed, standardized and validated tests of intellectual functioning and adaptive behavior, with onset during the developmental period from infancy through adolescence. Evidence: IEA. (OMIM:274800)
These phenotypes are associated with the disease thyroid dyshormonogenesis 4 (OMIM:274800).